- Autosomal dominant inheritance (HP:0000006): A mode of inheritance that is observed for traits related to a gene encoded on one of the autosomes (i.e., the human chromosomes 1-22) in which a trait manifests in heterozygotes. In the context of medical genetics, an autosomal dominant disorder is caused when a single copy of the mutant allele is present. Males and females are affected equally, and can both transmit the disorder with a risk of 50% for each child of inheriting the mutant allele. Evidence: TAS. (OMIM:614036)
This phenotype is associated with the disease 614036 ALPHA-2-MACROGLOBULIN DEFICIENCY; A2MD (OMIM:614036).